Phenotypes associated with the disease Pachygyria-intellectual disability-epilepsy syndrome (ORPHA:2798):
- Seizure (HP:0001250): A seizure is an intermittent abnormality of nervous system physiology characterized by a transient occurrence of signs and/or symptoms due to abnormal excessive or synchronous neuronal activity in the brain. Evidence: TAS. Frequency: Very frequent (HP:0040281). (ORPHA:2798)
- Global developmental delay (HP:0001263): A delay in the achievement of motor or mental milestones in the domains of development of a child, including motor skills, speech and language, cognitive skills, and social and emotional skills. This term should only be used to describe children younger than five years of age. Evidence: TAS. Frequency: Very frequent (HP:0040281). (ORPHA:2798)
- Premature birth (HP:0001622): The birth of a baby of less than 37 weeks of gestational age. Evidence: TAS. Frequency: Frequent (HP:0040282). (ORPHA:2798)
- Severe intellectual disability (HP:0010864): Severe intellectual disability (ID) is defined as a type of ID characterized by severely sub-average adaptive functioning and intellectual functioning, with an intelligence quotient (IQ) the range of 20-34. Evidence: TAS. Frequency: Very frequent (HP:0040281). (ORPHA:2798)